- Bifid uvula (HP:0000193): Uvula separated into two parts most easily seen at the tip. Evidence: IEA. (OMIM:192100)
- Autosomal dominant inheritance (HP:0000006): A mode of inheritance that is observed for traits related to a gene encoded on one of the autosomes (i.e., the human chromosomes 1-22) in which a trait manifests in heterozygotes. In the context of medical genetics, an autosomal dominant disorder is caused when a single copy of the mutant allele is present. Males and females are affected equally, and can both transmit the disorder with a risk of 50% for each child of inheriting the mutant allele. Evidence: IEA. (OMIM:192100)
These phenotypes are associated with the disease bifid uvula (OMIM:192100).